- Annular pancreas (HP:0001734): A congenital anomaly in which the pancreas completely (or sometimes incompletely) encircles the second portion of duodenum and occasionally obstructs the more proximal duodenum. Evidence: TAS. Frequency: Very frequent (HP:0040281). (ORPHA:675)
- High intestinal obstruction (HP:0005250). Evidence: TAS. Frequency: Frequent (HP:0040282). (ORPHA:675)
- Duodenal stenosis (HP:0100867): The narrowing or partial blockage of a portion of the duodenum. Evidence: TAS. Frequency: Very frequent (HP:0040281). (ORPHA:675)
These phenotypes are associated with the disease Annular pancreas (ORPHA:675).